Phenotypes associated with the disease ALG6-congenital disorder of glycosylation 1C (OMIM:603147):
- Type I transferrin isoform profile (HP:0003642): Abnormal transferrin isoform profile consistent with a type I congenital disorder of glycosylation. In the traditional nomenclature for congenital disorders of glycosylation, absence of entire glycans was designated type I, and loss of one or more monosaccharides as type II. Evidence: PCS. Frequency: 1/1. (PMID:11134235)
- Axial hypotonia (HP:0008936): Muscular hypotonia (abnormally low muscle tone) affecting the musculature of the trunk. Evidence: IEA. (OMIM:603147)
- Juvenile onset (HP:0003621): Onset of signs or symptoms of disease between the age of 5 and 15 years. Evidence: PCS. Frequency: 1/1. (PMID:11134235)
- Strabismus (HP:0000486): A misalignment of the eyes so that the visual axes deviate from bifoveal fixation. The classification of strabismus may be based on a number of features including the relative position of the eyes, whether the deviation is latent or manifest, intermittent or constant, concomitant or otherwise and according to the age of onset and the relevance of any associated refractive error. Evidence: IEA. (OMIM:603147)
- Seizure (HP:0001250): A seizure is an intermittent abnormality of nervous system physiology characterized by a transient occurrence of signs and/or symptoms due to abnormal excessive or synchronous neuronal activity in the brain. Evidence: PCS. Frequency: 1/1. (PMID:11134235)
- Global developmental delay (HP:0001263): A delay in the achievement of motor or mental milestones in the domains of development of a child, including motor skills, speech and language, cognitive skills, and social and emotional skills. This term should only be used to describe children younger than five years of age. Evidence: PCS. Frequency: 11/11. (OMIM:603147;PMID:11134235)
- Hypotonia (HP:0001252): Hypotonia is an abnormally low muscle tone (the amount of tension or resistance to movement in a muscle). Even when relaxed, muscles have a continuous and passive partial contraction which provides some resistance to passive stretching. Hypotonia thus manifests as diminished resistance to passive stretching. Hypotonia is not the same as muscle weakness, although the two conditions can co-exist. Evidence: PCS. Frequency: 1/1. (PMID:11134235)
- Ataxia (HP:0001251): Ataxia refers to impaired coordination of voluntary muscle movement. Cerebellar ataxia refers to ataxia due to dysfunction of the cerebellum. This causes a variety of elementary neurological deficits including asynergy (lack of coordination between muscles, limbs and joints), dysmetria (lack of ability to judge distances that can lead to under- or overshoot in grasping movements), and dysdiadochokinesia (inability to perform rapid movements requiring antagonizing muscle groups to be switched on and off repeatedly). Evidence: IEA. (OMIM:603147)
- Areflexia (HP:0001284): Absence of neurologic reflexes such as the knee-jerk reaction. Evidence: PCS. Frequency: 1/1. (PMID:11134235)
- Elevated serum transaminases during infections (HP:0008150): Elevations of the levels of SGOT (serum glutamic oxaloacetic transaminase) and SGPT (serum glutamic pyruvic transaminase) that occur during infections. Evidence: IEA. (OMIM:603147)
- Reduced factor XI activity (HP:0001929): Decreased activity of coagulation factor XI. Factor XI, also known as plasma thromboplastin antecedent, is a serine proteinase that activates factor IX. Evidence: IEA. (OMIM:603147)
- Autosomal recessive inheritance (HP:0000007): A mode of inheritance that is observed for traits related to a gene encoded on one of the autosomes (i.e., the human chromosomes 1-22) in which a trait manifests in individuals with two pathogenic alleles, either homozygotes (two copies of the same mutant allele) or compound heterozygotes (whereby each copy of a gene has a distinct mutant allele). Evidence: IEA. (OMIM:603147)
- Reduced antithrombin III activity (HP:0001976): An abnormality of coagulation related to a decreased concentration of antithrombin-III. Evidence: IEA. (OMIM:603147)